- Autosomal dominant inheritance (HP:0000006): A mode of inheritance that is observed for traits related to a gene encoded on one of the autosomes (i.e., the human chromosomes 1-22) in which a trait manifests in heterozygotes. In the context of medical genetics, an autosomal dominant disorder is caused when a single copy of the mutant allele is present. Males and females are affected equally, and can both transmit the disorder with a risk of 50% for each child of inheriting the mutant allele. Evidence: IEA. (OMIM:125540)
- Abnormality of the skin (HP:0000951): An abnormality of the skin. Evidence: IEA. (OMIM:125540)
These phenotypes are associated with the disease dermal Ridges, patternless (OMIM:125540).